- Abnormality of the nervous system (HP:0000707, a Human Phenotype Ontology term): An abnormality of the nervous system. Evidence: IEA. (OMIM:156220)
- Autosomal dominant inheritance (HP:0000006, a Human Phenotype Ontology term): A mode of inheritance that is observed for traits related to a gene encoded on one of the autosomes (i.e., the human chromosomes 1-22) in which a trait manifests in heterozygotes. In the context of medical genetics, an autosomal dominant disorder is caused when a single copy of the mutant allele is present. Males and females are affected equally, and can both transmit the disorder with a risk of 50% for each child of inheriting the mutant allele. Evidence: IEA. (OMIM:156220)
These phenotypes are associated with the disease meralgia paraesthetica, familial (OMIM:156220, an entry in Online Mendelian Inheritance in Man).